- Preauricular skin tag (HP:0000384): A rudimentary tag of skin often containing ear tissue including a core of cartilage and located just anterior to the auricle (outer part of the ear). Evidence: TAS. (OMIM:610420)
- Congenital onset (HP:0003577): A phenotypic abnormality that is present at birth. Evidence: TAS. (OMIM:610420)
- Autosomal dominant inheritance (HP:0000006): A mode of inheritance that is observed for traits related to a gene encoded on one of the autosomes (i.e., the human chromosomes 1-22) in which a trait manifests in heterozygotes. In the context of medical genetics, an autosomal dominant disorder is caused when a single copy of the mutant allele is present. Males and females are affected equally, and can both transmit the disorder with a risk of 50% for each child of inheriting the mutant allele. Evidence: TAS. (OMIM:610420)
These phenotypes are associated with the disease preauricular tag, isolated, autosomal dominant, 1 (OMIM:610420).